Phenotypes associated with the disease Malignant atrophic papulosis (ORPHA:679):
- Dermal atrophy (HP:0004334): Partial or complete wasting (atrophy) of the skin. Evidence: TAS. Frequency: Very frequent (HP:0040281). (ORPHA:679)
- Telangiectasia of the skin (HP:0100585): Presence of small, permanently dilated blood vessels near the surface of the skin, visible as small focal red lesions. Evidence: TAS. Frequency: Very frequent (HP:0040281). (ORPHA:679)
- Papule (HP:0200034): A circumscribed, solid elevation of skin with no visible fluid, varying in size from a pinhead to less than 10mm in diameter at the widest point. Evidence: TAS. Frequency: Very frequent (HP:0040281). (ORPHA:679)
- Weight loss (HP:0001824): Reduction of total body weight. Evidence: TAS. Frequency: Frequent (HP:0040282). (ORPHA:679)
- Nausea and vomiting (HP:0002017): Nausea is a commonly encountered symptom that has been defined as an unpleasant painless subjective feeling that one will imminently vomit. Vomiting has been defined as the forceful expulsion of the contents of the stomach, duodenum, or jejunum through the oral cavity. While nausea and vomiting are often thought to exist on a temporal continuum, this is not always the case. There are situations when severe nausea may be present without emesis and less frequently, when emesis may be present without preceding nausea. Evidence: TAS. Frequency: Frequent (HP:0040282). (ORPHA:679)
- Abdominal pain (HP:0002027): An unpleasant sensation characterized by physical discomfort (such as pricking, throbbing, or aching) and perceived to originate in the abdomen. Evidence: TAS. Frequency: Frequent (HP:0040282). (ORPHA:679)
- Gastrointestinal hemorrhage (HP:0002239): Hemorrhage affecting the gastrointestinal tract. Evidence: TAS. Frequency: Frequent (HP:0040282). (ORPHA:679)
- Gastrointestinal infarctions (HP:0005244). Evidence: TAS. Frequency: Frequent (HP:0040282). (ORPHA:679)
- Muscle flaccidity (HP:0010547): A type of paralysis in which a muscle becomes soft and yields to passive stretching, which results from loss of all or practically all peripheral motor nerves that innervated the muscle. Muscle tone is reduced and the affected muscles undergo extreme atrophy within months of the loss of innervation. Evidence: TAS. Frequency: Frequent (HP:0040282). (ORPHA:679)
- Fatigue (HP:0012378): A subjective feeling of tiredness characterized by a lack of energy and motivation. Evidence: TAS. Frequency: Frequent (HP:0040282). (ORPHA:679)
- Intestinal perforation (HP:0031368): A hole (perforation) in the wall of the intestine. Evidence: TAS. Frequency: Frequent (HP:0040282). (ORPHA:679)
- Ptosis (HP:0000508): The upper eyelid margin is positioned 3 mm or more lower than usual and covers the superior portion of the iris (objective); or, the upper lid margin obscures at least part of the pupil (subjective). Evidence: TAS. Frequency: Occasional (HP:0040283). (ORPHA:679)
- Cataract (HP:0000518): A cataract is an opacity or clouding that develops in the crystalline lens of the eye or in its capsule. Evidence: TAS. Frequency: Occasional (HP:0040283). (ORPHA:679)
- Abnormal optic nerve morphology (HP:0000587): Abnormality of the optic nerve. Evidence: TAS. Frequency: Occasional (HP:0040283). (ORPHA:679)
- Diplopia (HP:0000651): Diplopia is a condition in which a single object is perceived as two images, it is also known as double vision. Evidence: TAS. Frequency: Occasional (HP:0040283). (ORPHA:679)
- Seizure (HP:0001250): A seizure is an intermittent abnormality of nervous system physiology characterized by a transient occurrence of signs and/or symptoms due to abnormal excessive or synchronous neuronal activity in the brain. Evidence: TAS. Frequency: Occasional (HP:0040283). (ORPHA:679)
- Abnormal myocardium morphology (HP:0001637): A structural anomaly of the muscle layer of the heart wall. Evidence: TAS. Frequency: Occasional (HP:0040283). (ORPHA:679)
- Myocardial infarction (HP:0001658): Necrosis of the myocardium caused by an obstruction of the blood supply to the heart and often associated with chest pain, shortness of breath, palpitations, and anxiety as well as characteristic EKG findings and elevation of serum markers including creatine kinase-MB fraction and troponin. Evidence: TAS. Frequency: Occasional (HP:0040283). (ORPHA:679)
- Abnormal pericardium morphology (HP:0001697): An abnormality of the pericardium, i.e., of the fluid filled sac that surrounds the heart and the proximal ends of the aorta, vena cava, and the pulmonary artery. Evidence: TAS. Frequency: Occasional (HP:0040283). (ORPHA:679)
- Migraine (HP:0002076): Migraine is a chronic neurological disorder characterized by episodic attacks of headache and associated symptoms. Evidence: TAS. Frequency: Occasional (HP:0040283). (ORPHA:679)
- Ischemic stroke (HP:0002140): Acute ischemic stroke (AIS) is defined by the sudden loss of blood flow to an area of the brain with the resulting loss of neurologic function. It is caused by thrombosis or embolism that occludes a cerebral vessel supplying a specific area of the brain. During a vessel occlusion, there is a core area where damage to the brain is irreversible and an area of penumbra where the brain has lost function owing to decreased blood flow but is not irreversibly injured. Evidence: TAS. Frequency: Occasional (HP:0040283). (ORPHA:679)
- Pleural effusion (HP:0002202): The presence of an excessive amount of fluid in the pleural cavity. Evidence: TAS. Frequency: Occasional (HP:0040283). (ORPHA:679)
- Vertigo (HP:0002321): An abnormal sensation of spinning while the body is actually stationary. Evidence: TAS. Frequency: Occasional (HP:0040283). (ORPHA:679)
- Peritonitis (HP:0002586): Inflammation of the peritoneum. Evidence: TAS. Frequency: Occasional (HP:0040283). (ORPHA:679)
- Respiratory failure (HP:0002878): A severe form of respiratory insufficiency characterized by inadequate gas exchange such that the levels of oxygen or carbon dioxide cannot be maintained within normal limits. Evidence: TAS. Frequency: Occasional (HP:0040283). (ORPHA:679)
- Arterial thrombosis (HP:0004420): The formation of a blood clot inside an artery. Evidence: TAS. Frequency: Occasional (HP:0040283). (ORPHA:679)
- Cranial nerve paralysis (HP:0006824). Evidence: TAS. Frequency: Occasional (HP:0040283). (ORPHA:679)
- Pain insensitivity (HP:0007021): Inability to perceive painful stimuli. Evidence: TAS. Frequency: Occasional (HP:0040283). (ORPHA:679)
- Peripheral neuropathy (HP:0009830): Peripheral neuropathy is a general term for any disorder of the peripheral nervous system. The main clinical features used to classify peripheral neuropathy are distribution, type (mainly demyelinating versus mainly axonal), duration, and course. Evidence: TAS. Frequency: Occasional (HP:0040283). (ORPHA:679)
- Abnormality of the lower urinary tract (HP:0010936): An abnormality of the lower urinary tract. Evidence: TAS. Frequency: Occasional (HP:0040283). (ORPHA:679)
- Arteritis (HP:0012089): Arterial inflammation. Evidence: TAS. Frequency: Occasional (HP:0040283). (ORPHA:679)
- Amaurosis fugax (HP:0100576): A transient visual disturbance that is typically caused by a circulatory, ocular or neurological underlying condition. Evidence: TAS. Frequency: Occasional (HP:0040283). (ORPHA:679)
- Chest pain (HP:0100749): An unpleasant sensation characterized by physical discomfort (such as pricking, throbbing, or aching) localized to the chest. Evidence: TAS. Frequency: Occasional (HP:0040283). (ORPHA:679)
- Intestinal fistula (HP:0100819): An abnormal connection between the gut and another hollow organ, such as the bladder, urethra, vagina, or other regions of the gastrointestinal tract. Evidence: TAS. Frequency: Occasional (HP:0040283). (ORPHA:679)